- Triphalangeal thumb (HP:0001199): A thumb with three phalanges in a single, proximo-distal axis. Thus, this term applies if the thumb has an accessory phalanx, leading to a digit like appearance of the thumb. Evidence: TAS. (OMIM:605967)
- Moderate intellectual disability (HP:0002342): Moderate intellectual disability (ID) is defined as a type of ID characterized by moderately sub-average adaptive functioning and intellectual functioning, with an intelligence quotient (IQ) the range of 35-49. Evidence: TAS. Frequency: Occasional (HP:0040283). (OMIM:605967)
- Preaxial polydactyly (HP:0100258): A form of polydactyly in which the extra digit or digits are localized on the side of the thumb or great toe. Evidence: TAS. (OMIM:605967)
- Pectus excavatum (HP:0000767): A defect of the chest wall characterized by a depression of the sternum, giving the chest ("pectus") a caved-in ("excavatum") appearance. Evidence: TAS. (OMIM:605967)
- Pectus carinatum (HP:0000768): A deformity of the chest caused by overgrowth of the ribs and characterized by protrusion of the sternum. Evidence: TAS. (OMIM:605967)
- Partial duplication of thumb phalanx (HP:0009944): A partial duplication, depending on severity leading to a broad or bifid appearance, affecting one or more of the phalanges of the thumb. As opposed to a complete duplication there is still a variable degree of fusion between the duplicated bones. Evidence: TAS. (OMIM:605967)
- Autosomal dominant inheritance (HP:0000006): A mode of inheritance that is observed for traits related to a gene encoded on one of the autosomes (i.e., the human chromosomes 1-22) in which a trait manifests in heterozygotes. In the context of medical genetics, an autosomal dominant disorder is caused when a single copy of the mutant allele is present. Males and females are affected equally, and can both transmit the disorder with a risk of 50% for each child of inheriting the mutant allele. Evidence: TAS. (OMIM:605967)
These phenotypes are associated with the disease acropectoral syndrome (OMIM:605967).